Phenotypes associated with the disease GMPPB-related limb-girdle muscular dystrophy R19 (ORPHA:363623):
- Hypotonia (HP:0001252): Hypotonia is an abnormally low muscle tone (the amount of tension or resistance to movement in a muscle). Even when relaxed, muscles have a continuous and passive partial contraction which provides some resistance to passive stretching. Hypotonia thus manifests as diminished resistance to passive stretching. Hypotonia is not the same as muscle weakness, although the two conditions can co-exist. Evidence: TAS. Frequency: Frequent (HP:0040282). (ORPHA:363623)
- Global developmental delay (HP:0001263): A delay in the achievement of motor or mental milestones in the domains of development of a child, including motor skills, speech and language, cognitive skills, and social and emotional skills. This term should only be used to describe children younger than five years of age. Evidence: TAS. Frequency: Frequent (HP:0040282). (ORPHA:363623)
- Elevated circulating creatine kinase activity (HP:0003236): The activity of creatine kinase in the blood circulation is above the upper limit of normal. Evidence: TAS. Frequency: Frequent (HP:0040282). (ORPHA:363623)
- Difficulty climbing stairs (HP:0003551): Reduced ability to climb stairs. Evidence: TAS. Frequency: Frequent (HP:0040282). (ORPHA:363623)
- Microcephaly (HP:0000252): Head circumference below 2 standard deviations below the mean for age and gender. Evidence: TAS. Frequency: Occasional (HP:0040283). (ORPHA:363623)
- Neck muscle weakness (HP:0000467): Decreased strength of the neck musculature. Evidence: TAS. Frequency: Occasional (HP:0040283). (ORPHA:363623)
- Cataract (HP:0000518): A cataract is an opacity or clouding that develops in the crystalline lens of the eye or in its capsule. Evidence: TAS. Frequency: Occasional (HP:0040283). (ORPHA:363623)
- Nystagmus (HP:0000639): Rhythmic, involuntary oscillations of one or both eyes related to abnormality in fixation, conjugate gaze, or vestibular mechanisms. Evidence: TAS. Frequency: Occasional (HP:0040283). (ORPHA:363623)
- Muscle weakness (HP:0001324): Reduced strength of muscles. Evidence: TAS. Frequency: Occasional (HP:0040283). (ORPHA:363623)
- Cardiomyopathy (HP:0001638): A myocardial disorder in which the heart muscle is structurally and functionally abnormal, in the absence of coronary artery disease, hypertension, valvular disease and congenital heart disease sufficient to cause the observed myocardial abnormality. Evidence: TAS. Frequency: Occasional (HP:0040283). (ORPHA:363623)
- Respiratory insufficiency (HP:0002093). Evidence: TAS. Frequency: Occasional (HP:0040283). (ORPHA:363623)
- Axial muscle weakness (HP:0003327): Reduced strength of the axial musculature (i.e., of the muscles of the head and neck, spine, and ribs). Evidence: TAS. Frequency: Occasional (HP:0040283). (ORPHA:363623)
- Easy fatigability (HP:0003388): Increased susceptibility to fatigue. Evidence: TAS. Frequency: Occasional (HP:0040283). (ORPHA:363623)
- Muscle spasm (HP:0003394): Sudden and involuntary contractions of one or more muscles. Evidence: TAS. Frequency: Occasional (HP:0040283). (ORPHA:363623)
- EMG: decremental response of compound muscle action potential to repetitive nerve stimulation (HP:0003403): A compound muscle action potential (CMAP) is a type of electromyography (EMG). CMAP refers to a group of almost simultaneous action potentials from several muscle fibers in the same area evoked by stimulation of the supplying motor nerve and are recorded as one multipeaked summated action potential. This abnormality refers to a greater than normal decrease in the amplitude during the course of the investigation. Evidence: TAS. Frequency: Occasional (HP:0040283). (ORPHA:363623)
- Exercise intolerance (HP:0003546): A functional motor deficit where individuals whose responses to the challenges of exercise fail to achieve levels considered normal for their age and gender. Evidence: TAS. Frequency: Occasional (HP:0040283). (ORPHA:363623)
- Dilatation of the ventricular cavity (HP:0006698): A localized outpouching of ventricular cavity that is generally associated with dyskinesia and paradoxical expansion during systole. Evidence: TAS. Frequency: Occasional (HP:0040283). (ORPHA:363623)
- Lower limb muscle weakness (HP:0007340): Weakness of the muscles of the legs. Evidence: TAS. Frequency: Occasional (HP:0040283). (ORPHA:363623)
- Distal upper limb muscle weakness (HP:0008959): Reduced strength of the distal musculature of the arms. Evidence: TAS. Frequency: Occasional (HP:0040283). (ORPHA:363623)
- Proximal upper limb muscle weakness (HP:0008997): A lack of strength of the proximal muscles of the arms. Evidence: TAS. Frequency: Occasional (HP:0040283). (ORPHA:363623)
- Distal lower limb muscle weakness (HP:0009053): Reduced strength of the distal musculature of the legs. Evidence: TAS. Frequency: Occasional (HP:0040283). (ORPHA:363623)
- Fatigable weakness of bulbar muscles (HP:0030192): A type of weakness of the bulbar muscles (muscles of the mouth and throat responsible for speech and swallowing) that occurs after a muscle group is used and lessens if the muscle group has some rest. That is, there is diminution of strength with repetitive muscle actions. Evidence: TAS. Frequency: Occasional (HP:0040283). (ORPHA:363623)
- Cognitive impairment (HP:0100543): Abnormal cognition is characterized by deficits in thinking, reasoning, or remembering. Evidence: TAS. Frequency: Occasional (HP:0040283). (ORPHA:363623)
- Intellectual disability (HP:0001249): The term intellectual disability or intellectual developmental disorder is used to describe significantly sub-average intellectual and adaptive functioning based on clinical assessment and as measured by individually administered, appropriately normed, standardized and validated tests of intellectual functioning and adaptive behavior, with onset during the developmental period from infancy through adolescence. Evidence: TAS. Frequency: Frequent (HP:0040282). (ORPHA:363623)
- Seizure (HP:0001250): A seizure is an intermittent abnormality of nervous system physiology characterized by a transient occurrence of signs and/or symptoms due to abnormal excessive or synchronous neuronal activity in the brain. Evidence: TAS. Frequency: Frequent (HP:0040282). (ORPHA:363623)